- Juvenile onset (HP:0003621): Onset of signs or symptoms of disease between the age of 5 and 15 years. Evidence: PCS. (PMID:26196677)
- Abnormal vestibular function (HP:0001751): An abnormality of the functioning of the vestibular apparatus. Evidence: PCS. Frequency: 0/8. (PMID:26196677)
- Progressive sensorineural hearing impairment (HP:0000408): A progressive form of sensorineural hearing impairment. Evidence: PCS. Frequency: 8/8. (PMID:26196677)
- Adult onset (HP:0003581): Onset of disease manifestations in adulthood, defined here as at the age of 16 years or later. Evidence: PCS. (PMID:26196677)
- Autosomal dominant inheritance (HP:0000006): A mode of inheritance that is observed for traits related to a gene encoded on one of the autosomes (i.e., the human chromosomes 1-22) in which a trait manifests in heterozygotes. In the context of medical genetics, an autosomal dominant disorder is caused when a single copy of the mutant allele is present. Males and females are affected equally, and can both transmit the disorder with a risk of 50% for each child of inheriting the mutant allele. Evidence: PCS. (PMID:26196677)
- Slowly progressive (HP:0003677): Applies to a disease manifestation that only slowly increases in scope or severity over the course of time. Evidence: PCS. (PMID:26196677)
These phenotypes are associated with the disease autosomal dominant nonsyndromic hearing loss 70 (OMIM:616968).